Phenotypes associated with the disease thyroid cancer, nonmedullary, 3 (OMIM:606240):
- Non-medullary thyroid carcinoma (HP:0040198). Evidence: TAS. (OMIM:606240)
- Autosomal dominant inheritance (HP:0000006): A mode of inheritance that is observed for traits related to a gene encoded on one of the autosomes (i.e., the human chromosomes 1-22) in which a trait manifests in heterozygotes. In the context of medical genetics, an autosomal dominant disorder is caused when a single copy of the mutant allele is present. Males and females are affected equally, and can both transmit the disorder with a risk of 50% for each child of inheriting the mutant allele. Evidence: TAS. (OMIM:606240)